Phenotypes associated with the disease intellectual disability, X-linked 81 (OMIM:300433):
- X-linked recessive inheritance (HP:0001419): A mode of inheritance that is observed for recessive traits related to a gene encoded on the X chromosome. In the context of medical genetics, X-linked recessive disorders manifest in males (who have one copy of the X chromosome and are thus hemizygotes), but generally not in female heterozygotes who have one mutant and one normal allele. Evidence: TAS. (OMIM:300433)
- Intellectual disability (HP:0001249): The term intellectual disability or intellectual developmental disorder is used to describe significantly sub-average intellectual and adaptive functioning based on clinical assessment and as measured by individually administered, appropriately normed, standardized and validated tests of intellectual functioning and adaptive behavior, with onset during the developmental period from infancy through adolescence. Evidence: TAS. (OMIM:300433)